- Abnormal patella morphology (HP:0003045): Abnormality of the patella (knee cap). Evidence: IEA. (OMIM:168900)
- Autosomal dominant inheritance (HP:0000006): A mode of inheritance that is observed for traits related to a gene encoded on one of the autosomes (i.e., the human chromosomes 1-22) in which a trait manifests in heterozygotes. In the context of medical genetics, an autosomal dominant disorder is caused when a single copy of the mutant allele is present. Males and females are affected equally, and can both transmit the disorder with a risk of 50% for each child of inheriting the mutant allele. Evidence: IEA. (OMIM:168900)
These phenotypes are associated with the disease chondromalacia patellae (OMIM:168900).